Phenotypes associated with the disease varicella, severe recurrent (OMIM:600670):
- Autosomal recessive inheritance (HP:0000007): A mode of inheritance that is observed for traits related to a gene encoded on one of the autosomes (i.e., the human chromosomes 1-22) in which a trait manifests in individuals with two pathogenic alleles, either homozygotes (two copies of the same mutant allele) or compound heterozygotes (whereby each copy of a gene has a distinct mutant allele). Evidence: TAS. (OMIM:600670)
- Severe recurrent varicella (HP:0005428). Evidence: IEA. (OMIM:600670)